- Progressive (HP:0003676): Applies to a disease manifestation that increases in scope or severity over the course of time, i.e., that worsens with age. Evidence: PCS. (PMID:28013291)
- Sensorineural hearing impairment (HP:0000407): A type of hearing impairment in one or both ears related to an abnormal functionality of the cochlear nerve. Evidence: PCS. (PMID:28013291)
- Young adult onset (HP:0011462): Onset of disease at the age of between 16 and 40 years. Evidence: PCS. (PMID:28013291)
- Tinnitus (HP:0000360): Tinnitus is an auditory perception that can be described as the experience of sound, in the ear or in the head, in the absence of external acoustic stimulation. Evidence: PCS. (PMID:28013291)
- Autosomal dominant inheritance (HP:0000006): A mode of inheritance that is observed for traits related to a gene encoded on one of the autosomes (i.e., the human chromosomes 1-22) in which a trait manifests in heterozygotes. In the context of medical genetics, an autosomal dominant disorder is caused when a single copy of the mutant allele is present. Males and females are affected equally, and can both transmit the disorder with a risk of 50% for each child of inheriting the mutant allele. Evidence: PCS. (PMID:28013291)
These phenotypes are associated with the disease hearing loss, autosomal dominant 72 (OMIM:617606).